- Hydrocephalus (HP:0000238): Hydrocephalus is an active distension of the ventricular system of the brain resulting from inadequate passage of CSF from its point of production within the cerebral ventricles to its point of absorption into the systemic circulation. Evidence: TAS. Frequency: Occasional (HP:0040283). (ORPHA:381)
- Abnormal eyelash morphology (HP:0000499): An abnormality of the eyelashes. Evidence: TAS. Frequency: Occasional (HP:0040283). (ORPHA:381)
- Abnormal eyebrow morphology (HP:0000534): An abnormality of the eyebrow. Evidence: TAS. Frequency: Occasional (HP:0040283). (ORPHA:381)
- Nystagmus (HP:0000639): Rhythmic, involuntary oscillations of one or both eyes related to abnormality in fixation, conjugate gaze, or vestibular mechanisms. Evidence: TAS. Frequency: Occasional (HP:0040283). (ORPHA:381)
- Jaundice (HP:0000952): Yellow pigmentation of the skin due to bilirubin, which in turn is the result of increased bilirubin concentration in the bloodstream. Evidence: TAS. Frequency: Occasional (HP:0040283). (ORPHA:381)
- Hypopigmented skin patches (HP:0001053). Evidence: TAS. Frequency: Very frequent (HP:0040281). (ORPHA:381)
- Intellectual disability (HP:0001249): The term intellectual disability or intellectual developmental disorder is used to describe significantly sub-average intellectual and adaptive functioning based on clinical assessment and as measured by individually administered, appropriately normed, standardized and validated tests of intellectual functioning and adaptive behavior, with onset during the developmental period from infancy through adolescence. Evidence: TAS. Frequency: Occasional (HP:0040283). (ORPHA:381)
- Seizure (HP:0001250): A seizure is an intermittent abnormality of nervous system physiology characterized by a transient occurrence of signs and/or symptoms due to abnormal excessive or synchronous neuronal activity in the brain. Evidence: TAS. Frequency: Occasional (HP:0040283). (ORPHA:381)
- Ataxia (HP:0001251): Ataxia refers to impaired coordination of voluntary muscle movement. Cerebellar ataxia refers to ataxia due to dysfunction of the cerebellum. This causes a variety of elementary neurological deficits including asynergy (lack of coordination between muscles, limbs and joints), dysmetria (lack of ability to judge distances that can lead to under- or overshoot in grasping movements), and dysdiadochokinesia (inability to perform rapid movements requiring antagonizing muscle groups to be switched on and off repeatedly). Evidence: TAS. Frequency: Occasional (HP:0040283). (ORPHA:381)
- Hypotonia (HP:0001252): Hypotonia is an abnormally low muscle tone (the amount of tension or resistance to movement in a muscle). Even when relaxed, muscles have a continuous and passive partial contraction which provides some resistance to passive stretching. Hypotonia thus manifests as diminished resistance to passive stretching. Hypotonia is not the same as muscle weakness, although the two conditions can co-exist. Evidence: TAS. Frequency: Occasional (HP:0040283). (ORPHA:381)
- Spasticity (HP:0001257): A motor disorder characterized by a velocity-dependent increase in tonic stretch reflexes with increased muscle tone, exaggerated (hyperexcitable) tendon reflexes. Evidence: TAS. Frequency: Occasional (HP:0040283). (ORPHA:381)
- Global developmental delay (HP:0001263): A delay in the achievement of motor or mental milestones in the domains of development of a child, including motor skills, speech and language, cognitive skills, and social and emotional skills. This term should only be used to describe children younger than five years of age. Evidence: TAS. Frequency: Occasional (HP:0040283). (ORPHA:381)
- Diminished deep tendon reflex (HP:0001315): A reduction (hyporeflexia) or complete absence (areflexia) of the involuntary muscle contraction normally elicited by a reflex stimulus, such as tapping a deep tendon. Evidence: TAS. Frequency: Frequent (HP:0040282). (ORPHA:381)
- Ascites (HP:0001541): Accumulation of fluid in the peritoneal cavity (between the layers of the peritoneum that lines the abdomen). Evidence: TAS. Frequency: Occasional (HP:0040283). (ORPHA:381)
- Splenomegaly (HP:0001744): Abnormal increased size of the spleen. Evidence: TAS. Frequency: Occasional (HP:0040283). (ORPHA:381)
- Thrombocytopenia (HP:0001873): A reduction in the number of circulating thrombocytes. Evidence: TAS. Frequency: Frequent (HP:0040282). (ORPHA:381)
- Abnormality of neutrophils (HP:0001874): A neutrophil abnormality. Evidence: TAS. Frequency: Frequent (HP:0040282). (ORPHA:381)
- Decreased total leukocyte count (HP:0001882): An abnormal decreased number of leukocytes in the blood. Evidence: TAS. Frequency: Frequent (HP:0040282). (ORPHA:381)
- Fever (HP:0001945): Body temperature elevated above the normal range. Evidence: TAS. Frequency: Occasional (HP:0040283). (ORPHA:381)
- Pyloric stenosis (HP:0002021): Pyloric stenosis, also known as infantile hypertrophic pyloric stenosis, is an uncommon condition in infants characterized by abnormal thickening of the pylorus muscles in the stomach leading to gastric outlet obstruction. Clinically infants are well at birth. Then, at 3 to 6 weeks of age, the infants present with projectile vomiting, potentially leading to dehydration and weight loss. Evidence: TAS. Frequency: Occasional (HP:0040283). (ORPHA:381)
- Encephalocele (HP:0002084): A neural tube defect characterized by sac-like protrusions of the brain and the membranes that cover it through openings in the skull. Evidence: TAS. Frequency: Occasional (HP:0040283). (ORPHA:381)
- Premature graying of hair (HP:0002216): Development of gray hair at a younger than normal age. Evidence: TAS. Frequency: Very frequent (HP:0040281). (ORPHA:381)
- Silver-gray hair (HP:0002218): Hypopigmented hair that appears silver-gray. Evidence: TAS. Frequency: Very frequent (HP:0040281). (ORPHA:381)
- Hepatomegaly (HP:0002240): Abnormally increased size of the liver. Evidence: TAS. Frequency: Occasional (HP:0040283). (ORPHA:381)
- Lymphadenopathy (HP:0002716): Enlargement (swelling) of a lymph node. Evidence: TAS. Frequency: Frequent (HP:0040282). (ORPHA:381)
- Immunodeficiency (HP:0002721): Failure of the immune system to protect the body adequately from infection, due to the absence or insufficiency of some component process or substance. Evidence: TAS. Frequency: Frequent (HP:0040282). (ORPHA:381)
- Abnormal circulating lipid concentration (HP:0003119): Any deviation from the normal concentration of a lipid in the blood circulation. Evidence: TAS. Frequency: Frequent (HP:0040282). (ORPHA:381)
- Decreased circulating immunoglobulin concentration (HP:0004313): An abnormally decreased level of immunoglobulin in blood. Evidence: TAS. Frequency: Frequent (HP:0040282). (ORPHA:381)
- Short stature (HP:0004322): A height below that which is expected according to age and gender norms. Although there is no universally accepted definition of short stature, many refer to "short stature" as height more than 2 standard deviations below the mean for age and gender (or below the 3rd percentile for age and gender dependent norms). Evidence: TAS. Frequency: Occasional (HP:0040283). (ORPHA:381)
- Bone marrow hypocellularity (HP:0005528): A reduced number of hematopoietic cells present in the bone marrow relative to marrow fat. Evidence: TAS. Frequency: Occasional (HP:0040283). (ORPHA:381)
- Cranial nerve paralysis (HP:0006824). Evidence: TAS. Frequency: Occasional (HP:0040283). (ORPHA:381)
- Iris hypopigmentation (HP:0007730): An abnormal reduction in the amount of pigmentation of the iris. Evidence: TAS. Frequency: Occasional (HP:0040283). (ORPHA:381)
- Pedal edema (HP:0010741): An abnormal accumulation of excess fluid in the lower extremity resulting in swelling of the feet and extending upward to the lower leg. Evidence: TAS. Frequency: Occasional (HP:0040283). (ORPHA:381)
- White hair (HP:0011364): Hypopigmented hair that appears white. Evidence: TAS. Frequency: Very frequent (HP:0040281). (ORPHA:381)
- Hepatitis (HP:0012115): Inflammation of the liver. Evidence: TAS. Frequency: Occasional (HP:0040283). (ORPHA:381)
- Abnormality of movement (HP:0100022): An abnormality of movement with a neurological basis characterized by changes in coordination and speed of voluntary movements. Evidence: TAS. Frequency: Occasional (HP:0040283). (ORPHA:381)
These phenotypes are associated with the disease Griscelli syndrome (ORPHA:381).